Phenotypes associated with the disease Alpha-Fetoprotein deficiency (OMIM:615969):
- Autosomal recessive inheritance (HP:0000007): A mode of inheritance that is observed for traits related to a gene encoded on one of the autosomes (i.e., the human chromosomes 1-22) in which a trait manifests in individuals with two pathogenic alleles, either homozygotes (two copies of the same mutant allele) or compound heterozygotes (whereby each copy of a gene has a distinct mutant allele). Evidence: PCS. (PMID:15280901)
- Decreased circulating alpha-fetoprotein concentration (HP:0045057): The concentration of alpha-fetoprotein in the blood circulation is below the lower limit of normal. Evidence: PCS. (PMID:15280901)